Phenotypes associated with the disease elastosis perforans serpiginosa (OMIM:130100):
- Nevus (HP:0003764): A nevus is a type of hamartoma that is a circumscribed stable malformation of the skin. Evidence: IEA. (OMIM:130100)
- Autosomal dominant inheritance (HP:0000006): A mode of inheritance that is observed for traits related to a gene encoded on one of the autosomes (i.e., the human chromosomes 1-22) in which a trait manifests in heterozygotes. In the context of medical genetics, an autosomal dominant disorder is caused when a single copy of the mutant allele is present. Males and females are affected equally, and can both transmit the disorder with a risk of 50% for each child of inheriting the mutant allele. Evidence: IEA. (OMIM:130100)